- Abnormality of the nervous system (HP:0000707): An abnormality of the nervous system. Evidence: IEA. (OMIM:222500)
- Autosomal recessive inheritance (HP:0000007): A mode of inheritance that is observed for traits related to a gene encoded on one of the autosomes (i.e., the human chromosomes 1-22) in which a trait manifests in individuals with two pathogenic alleles, either homozygotes (two copies of the same mutant allele) or compound heterozygotes (whereby each copy of a gene has a distinct mutant allele). Evidence: TAS. (OMIM:222500)
These phenotypes are associated with the disease diastematomyelia (OMIM:222500).